Phenotypes associated with the disease Fetal valproate spectrum disorder (ORPHA:1906):
- Narrow mouth (HP:0000160): Distance between the commissures of the mouth more than 2 SD below the mean. Alternatively, an apparently decreased width of the oral aperture (subjective). Evidence: TAS. Frequency: Very frequent (HP:0040281). (ORPHA:1906)
- Thin vermilion border (HP:0000233): Height of the vermilion of the medial part of the lip more than 2 SD below the mean, or apparently reduced height of the vermilion of the lip in the frontal view. The vermilion is the red part of the lips (and confusingly, the vermilion itself is also often referred to as being equivalent the lips). Evidence: TAS. Frequency: Very frequent (HP:0040281). (ORPHA:1906)
- Epicanthus (HP:0000286): A fold of skin starting above the medial aspect of the upper eyelid and arching downward to cover, pass in front of and lateral to the medial canthus. Evidence: TAS. Frequency: Very frequent (HP:0040281). (ORPHA:1906)
- Long philtrum (HP:0000343): Distance between nasal base and midline upper lip vermilion border more than 2 SD above the mean. Alternatively, an apparently increased distance between nasal base and midline upper lip vermilion border. Evidence: TAS. Frequency: Very frequent (HP:0040281). (ORPHA:1906)
- Depressed nasal ridge (HP:0000457): Lack of prominence of the nose resulting from a posteriorly-placed nasal ridge. Evidence: TAS. Frequency: Very frequent (HP:0040281). (ORPHA:1906)
- Omphalocele (HP:0001539): A midline anterior incomplete closure of the abdominal wall in which there is herniation of the abdominal viscera into the base of the abdominal cord. Evidence: TAS. Frequency: Very frequent (HP:0040281). (ORPHA:1906)
- Downturned corners of mouth (HP:0002714): A morphological abnormality of the mouth in which the angle of the mouth is downturned. The oral commissures are positioned inferior to the midline labial fissure. Evidence: TAS. Frequency: Very frequent (HP:0040281). (ORPHA:1906)
- Short nose (HP:0003196): Distance from nasion to subnasale more than two standard deviations below the mean, or alternatively, an apparently decreased length from the nasal root to the nasal tip. Evidence: TAS. Frequency: Very frequent (HP:0040281). (ORPHA:1906)